- Foam cells (HP:0003651): The presence of foam cells, a type of macrophage that localizes to fatty deposits on blood vessel walls, where they ingest low-density lipoproteins and become laden with lipids, giving them a foamy appearance. Evidence: IEA. (OMIM:607625)
- Dystonia (HP:0001332): An abnormally increased muscular tone that causes fixed abnormal postures. There is a slow, intermittent twisting motion that leads to exaggerated turning and posture of the extremities and trunk. Evidence: IEA. (OMIM:607625)
- Seizure (HP:0001250): A seizure is an intermittent abnormality of nervous system physiology characterized by a transient occurrence of signs and/or symptoms due to abnormal excessive or synchronous neuronal activity in the brain. Evidence: IEA. (OMIM:607625)
- Fetal ascites (HP:0001791): Accumulation of fluid in the peritoneal cavity during the fetal period. Evidence: IEA. (OMIM:607625)
- Fetal ascites (HP:0001791): Accumulation of fluid in the peritoneal cavity during the fetal period. Evidence: PCS. Frequency: 1/8. Onset: Fetal onset (HP:0011461). (PMID:11567215)
- Hypotonia (HP:0001252): Hypotonia is an abnormally low muscle tone (the amount of tension or resistance to movement in a muscle). Even when relaxed, muscles have a continuous and passive partial contraction which provides some resistance to passive stretching. Hypotonia thus manifests as diminished resistance to passive stretching. Hypotonia is not the same as muscle weakness, although the two conditions can co-exist. Evidence: IEA. (OMIM:607625)
- Ataxia (HP:0001251): Ataxia refers to impaired coordination of voluntary muscle movement. Cerebellar ataxia refers to ataxia due to dysfunction of the cerebellum. This causes a variety of elementary neurological deficits including asynergy (lack of coordination between muscles, limbs and joints), dysmetria (lack of ability to judge distances that can lead to under- or overshoot in grasping movements), and dysdiadochokinesia (inability to perform rapid movements requiring antagonizing muscle groups to be switched on and off repeatedly). Evidence: IEA. (OMIM:607625)
- Hepatomegaly (HP:0002240): Abnormally increased size of the liver. Evidence: PCS. Frequency: 5/8. (PMID:11567215)
- Neurofibrillary tangles (HP:0002185): Pathological protein aggregates formed by hyperphosphorylation of a microtubule-associated protein known as tau, causing it to aggregate in an insoluble form. Evidence: IEA. (OMIM:607625)
- Childhood onset (HP:0011463): Onset of disease at the age of between 1 and 5 years. Evidence: PCS. Frequency: 2/8. (PMID:11567215)
- Motor stereotypy (HP:0000733): Use of the same abnormal action in response to certain triggers or at random. They may be used as a way to regulate one's internal state but must otherwise have no apparent functional purpose. Evidence: IEA. (OMIM:607625)
- Respiratory failure (HP:0002878): A severe form of respiratory insufficiency characterized by inadequate gas exchange such that the levels of oxygen or carbon dioxide cannot be maintained within normal limits. Evidence: TAS. (OMIM:607625)
- Low cholesterol esterification rate (HP:0003349): A reduction in the rate of cholesterol esterification. Evidence: PCS. Frequency: 8/8. (PMID:11567215)
- Death in infancy (HP:0001522): Death within the first 24 months of life. Evidence: PCS. Frequency: 4/8. (PMID:11567215)
- Intellectual disability (HP:0001249): The term intellectual disability or intellectual developmental disorder is used to describe significantly sub-average intellectual and adaptive functioning based on clinical assessment and as measured by individually administered, appropriately normed, standardized and validated tests of intellectual functioning and adaptive behavior, with onset during the developmental period from infancy through adolescence. Evidence: IEA. (OMIM:607625)
- Prolonged neonatal jaundice (HP:0006579): Neonatal jaundice refers to a yellowing of the skin and other tissues of a newborn infant as a result of increased concentrations of bilirubin in the blood. Neonatal jaundice affects over half of all newborns to some extent in the first week of life. Prolonged neonatal jaundice is said to be present if the jaundice persists for longer than 14 days in term infants and 21 days in preterm infants. Evidence: IEA. (OMIM:607625)
- Splenomegaly (HP:0001744): Abnormal increased size of the spleen. Evidence: PCS. Frequency: 5/8. (PMID:11567215)
- Jaundice (HP:0000952): Yellow pigmentation of the skin due to bilirubin, which in turn is the result of increased bilirubin concentration in the bloodstream. Evidence: PCS. Frequency: 5/8. (PMID:11567215)
- Vertical supranuclear gaze palsy (HP:0000511): A supranuclear gaze palsy is an inability to look in a vertical direction as a result of cerebral impairment. There is a loss of the voluntary aspect of eye movements, but, as the brainstem is still intact, all the reflex conjugate eye movements are normal. Evidence: IEA. (OMIM:607625)
- Neonatal onset (HP:0003623): Onset of signs or symptoms of disease within the first 28 days of life. Evidence: PCS. Frequency: 6/8. (PMID:11567215)
- Elevated circulating C-triol concentration (HP:6001353): The concentration of cholestane-3beta, 5alpha, 6beta-triol (C-triol) in the blood circulation is above the upper limit of normal. C-triol is a diagnostic biomarker for Niemann-Pick disease type C. Evidence: PCS. (PMID:26981555)
- Dysphagia (HP:0002015): Difficulty in swallowing. Evidence: IEA. (OMIM:607625)
- Polyhydramnios (HP:0001561): The presence of excess amniotic fluid in the uterus during pregnancy. Evidence: PCS. Frequency: 1/8. (PMID:11567215)
- CNS foam cells (HP:0003640): The presence of foam cells, a type of macrophage that localizes to fatty deposits on blood vessel walls, in the central nervous system. Evidence: IEA. (OMIM:607625)
- Sea-blue histiocytosis (HP:0001982): An abnormality of histiocytes, in which the cells take on a sea blue appearance due to abnormally increased lipid content. Histiocytes are a type of macrophage. Sea-blue histiocytes are typically large macrophages from 20 to 60 micrometers in diameter with a single eccentric nucleus whose cytoplasm if packed with sea-blue or blue-green granules when stained with Wright-Giemsa. Evidence: IEA. (OMIM:607625)
- Bone-marrow foam cells (HP:0004333): The presence of foam cells in the bone marrow, generally demonstrated by bone-marrow aspiration or biopsy. Foam cells have a vacuolated appearance due to the presence of complex lipid deposits, giving them a foamy or soap-suds appearance. Evidence: IEA. (OMIM:607625)
- Perseverative thought (HP:0030223): The repetitive production of the same response to different commands. Evidence: TAS. (OMIM:607625)
- Dysarthria (HP:0001260): Dysarthric speech is a general description referring to a neurological speech disorder characterized by poor articulation. Depending on the involved neurological structures, dysarthria may be further classified as spastic, flaccid, ataxic, hyperkinetic and hypokinetic, or mixed. Evidence: IEA. (OMIM:607625)
- Global developmental delay (HP:0001263): A delay in the achievement of motor or mental milestones in the domains of development of a child, including motor skills, speech and language, cognitive skills, and social and emotional skills. This term should only be used to describe children younger than five years of age. Evidence: PCS. (PMID:11567215)
- Loss of speech (HP:0002371). Evidence: IEA. (OMIM:607625)
- Respiratory insufficiency (HP:0002093). Evidence: PCS. Frequency: 7/8. (PMID:11567215)
- Psychosis (HP:0000709): A condition characterized by changes in personality and thought patterns, often accompanied by hallucinations and delusional beliefs, is known as psychosis. Evidence: IEA. (OMIM:607625)
- Death in childhood (HP:0003819): Death in during childhood, defined here as between the ages of 2 and 10 years. Evidence: PCS. Frequency: 2/8. (PMID:11567215)
- Dementia (HP:0000726): A loss of global cognitive ability of sufficient amount to interfere with normal social or occupational function. Dementia represents a loss of previously present cognitive abilities, generally in adults, and can affect memory, thinking, language, judgment, and behavior. Evidence: IEA. (OMIM:607625)
- Autosomal recessive inheritance (HP:0000007): A mode of inheritance that is observed for traits related to a gene encoded on one of the autosomes (i.e., the human chromosomes 1-22) in which a trait manifests in individuals with two pathogenic alleles, either homozygotes (two copies of the same mutant allele) or compound heterozygotes (whereby each copy of a gene has a distinct mutant allele). Evidence: PCS. (PMID:11567215)
- Cataplexy (HP:0002524): A sudden and transient episode of bilateral loss of muscle tone, often triggered by emotions. Evidence: IEA. (OMIM:607625)
- Spasticity (HP:0001257): A motor disorder characterized by a velocity-dependent increase in tonic stretch reflexes with increased muscle tone, exaggerated (hyperexcitable) tendon reflexes. Evidence: IEA. (OMIM:607625)
- Pulmonary fibrosis (HP:0002206): Replacement of normal lung tissues by fibroblasts and collagen. Evidence: PCS. Frequency: 1/1. (PMID:11567215)
- Neonatal respiratory distress (HP:0002643): Respiratory difficulty as newborn. Evidence: PCS. Frequency: 1/8. Onset: Neonatal onset (HP:0003623). (PMID:11567215)
These phenotypes are associated with the disease Niemann-Pick disease, type C2 (OMIM:607625).